- Autoimmunity (HP:0002960): The occurrence of an immune reaction against the organism's own cells or tissues. Evidence: IEA. (OMIM:109100)
- Autoimmune antibody positivity (HP:0030057): The presence of an antibody in the blood circulation that is directed against the organism's own cells or tissues. Evidence: IEA. (OMIM:109100)
- Autosomal dominant inheritance (HP:0000006): A mode of inheritance that is observed for traits related to a gene encoded on one of the autosomes (i.e., the human chromosomes 1-22) in which a trait manifests in heterozygotes. In the context of medical genetics, an autosomal dominant disorder is caused when a single copy of the mutant allele is present. Males and females are affected equally, and can both transmit the disorder with a risk of 50% for each child of inheriting the mutant allele. Evidence: TAS. (OMIM:109100)
These phenotypes are associated with the disease autoimmune disease (OMIM:109100).